Phenotypes associated with the disease pseudohyperaldosteronism type 2 (OMIM:605115):
- Decreased circulating renin concentration (HP:0003351): An decreased level of renin in the blood. Evidence: TAS. (OMIM:605115)
- Hypertension (HP:0000822): The presence of chronic increased pressure in the systemic arterial system. Evidence: TAS. (OMIM:605115)
- Decreased circulating aldosterone concentration (HP:0004319): Abnormally reduced levels of aldosterone. Evidence: TAS. (OMIM:605115)
- Autosomal dominant inheritance (HP:0000006): A mode of inheritance that is observed for traits related to a gene encoded on one of the autosomes (i.e., the human chromosomes 1-22) in which a trait manifests in heterozygotes. In the context of medical genetics, an autosomal dominant disorder is caused when a single copy of the mutant allele is present. Males and females are affected equally, and can both transmit the disorder with a risk of 50% for each child of inheriting the mutant allele. Evidence: TAS. (OMIM:605115)
- Maternal hypertension (HP:0008071): Increased blood pressure during a pregnancy. Evidence: PCS. (PMID:10884226)